- Hypopigmentation of hair (HP:0005599). Evidence: TAS. Frequency: Very frequent (HP:0040281). (ORPHA:79478)
- Partial albinism (HP:0007443): Absence of melanin pigment in various areas, which is found at birth and is permanent. The lesions are known as leucoderma and are often found on the face, trunk, or limbs. Evidence: TAS. Frequency: Occasional (HP:0040283). (ORPHA:79478)
- Iris hypopigmentation (HP:0007730): An abnormal reduction in the amount of pigmentation of the iris. Evidence: TAS. Frequency: Occasional (HP:0040283). (ORPHA:79478)
These phenotypes are associated with the disease Griscelli syndrome type 3 (ORPHA:79478).